- Dolichocephaly (HP:0000268): An abnormality of skull shape characterized by a increased anterior-posterior diameter, i.e., an increased antero-posterior dimension of the skull. Cephalic index less than 76%. Alternatively, an apparently increased antero-posterior length of the head compared to width. Often due to premature closure of the sagittal suture. Evidence: IEA. (OMIM:609579)
- Intellectual disability (HP:0001249): The term intellectual disability or intellectual developmental disorder is used to describe significantly sub-average intellectual and adaptive functioning based on clinical assessment and as measured by individually administered, appropriately normed, standardized and validated tests of intellectual functioning and adaptive behavior, with onset during the developmental period from infancy through adolescence. Evidence: IEA. (OMIM:609579)
These phenotypes are associated with the disease familial scaphocephaly syndrome, McGillivray type (OMIM:609579).